- Upslanted palpebral fissure (HP:0000582): The palpebral fissure inclination is more than two standard deviations above the mean for age (objective); or, the inclination of the palpebral fissure is greater than typical for age. Evidence: TAS. (OMIM:611107)
- Microcephaly (HP:0000252): Head circumference below 2 standard deviations below the mean for age and gender. Evidence: TAS. (OMIM:611107)
- Global developmental delay (HP:0001263): A delay in the achievement of motor or mental milestones in the domains of development of a child, including motor skills, speech and language, cognitive skills, and social and emotional skills. This term should only be used to describe children younger than five years of age. Evidence: TAS. (OMIM:611107)
- Malar flattening (HP:0000272): Underdevelopment of the malar prominence of the jugal bone (zygomatic bone in mammals), appreciated in profile, frontal view, and/or by palpation. Evidence: TAS. (OMIM:611107)
- Delayed myelination (HP:0012448): Delayed myelination. Evidence: TAS. (OMIM:611107)
- Autosomal recessive inheritance (HP:0000007): A mode of inheritance that is observed for traits related to a gene encoded on one of the autosomes (i.e., the human chromosomes 1-22) in which a trait manifests in individuals with two pathogenic alleles, either homozygotes (two copies of the same mutant allele) or compound heterozygotes (whereby each copy of a gene has a distinct mutant allele). Evidence: TAS. (OMIM:611107)
- Intellectual disability (HP:0001249): The term intellectual disability or intellectual developmental disorder is used to describe significantly sub-average intellectual and adaptive functioning based on clinical assessment and as measured by individually administered, appropriately normed, standardized and validated tests of intellectual functioning and adaptive behavior, with onset during the developmental period from infancy through adolescence. Evidence: TAS. (OMIM:611107)
These phenotypes are associated with the disease intellectual disability, autosomal recessive 4 (OMIM:611107).